- Abnormal corpus callosum morphology (HP:0001273): Abnormality of the corpus callosum. Evidence: TAS. Frequency: Very frequent (HP:0040281). (ORPHA:221074)
- Malnutrition (HP:0004395): A deficiency in the intake of energy and nutrients. Evidence: TAS. Frequency: Very frequent (HP:0040281). (ORPHA:221074)
- Addictive alcohol use (HP:0030955): An addictive behavior is defined as drinking excessive amounts of alcohol over a prolonged period of time, having difficulty in reducing the amount of alcohol consumed, strongly desiring alcohol, and experiencing withdrawal symptoms when not drinking alcohol. Evidence: TAS. Frequency: Very frequent (HP:0040281). (ORPHA:221074)
- Decreased circulating vitamin B1 concentration (HP:0100503): The concentration of vitamin B1 in the blood circulation is below the lower limit of normal. Evidence: TAS. Frequency: Very frequent (HP:0040281). (ORPHA:221074)
- Coma (HP:0001259): The complete absence of wakefulness and consciousness, which is evident through a lack of response to any form of external stimuli. Evidence: TAS. Frequency: Frequent (HP:0040282). (ORPHA:221074)
- Dysarthria (HP:0001260): Dysarthric speech is a general description referring to a neurological speech disorder characterized by poor articulation. Depending on the involved neurological structures, dysarthria may be further classified as spastic, flaccid, ataxic, hyperkinetic and hypokinetic, or mixed. Evidence: TAS. Frequency: Frequent (HP:0040282). (ORPHA:221074)
- Gait disturbance (HP:0001288): The term gait disturbance can refer to any disruption of the ability to walk. Evidence: TAS. Frequency: Frequent (HP:0040282). (ORPHA:221074)
- Gait ataxia (HP:0002066): A type of ataxia characterized by the impairment of the ability to coordinate the movements required for normal walking. Gait ataxia is characteirzed by a wide-based staggering gait with a tendency to fall. Evidence: TAS. Frequency: Frequent (HP:0040282). (ORPHA:221074)
- Headache (HP:0002315): Cephalgia, or pain sensed in various parts of the head, not confined to the area of distribution of any nerve. Evidence: TAS. Frequency: Frequent (HP:0040282). (ORPHA:221074)
- Memory impairment (HP:0002354): An impairment of memory as manifested by a reduced ability to remember things such as dates and names, and increased forgetfulness. Evidence: TAS. Frequency: Frequent (HP:0040282). (ORPHA:221074)
- Limb hypertonia (HP:0002509). Evidence: TAS. Frequency: Frequent (HP:0040282). (ORPHA:221074)
- Loss of consciousness (HP:0007185): Loss of awareness of oneself or one's surroundings, involving (i) a loss of normal motor control is evident as flaccidity or stiffness, either of which can be accompanied by jerking movements, and postural control is lost so that patients fall if they are in an upright position; (ii) normal responsiveness is lost; and (iii) the patient experiences amnesia for the event. Loss of consciousness my be transitory (e.g., syncope) or prolonged. Evidence: TAS. Frequency: Frequent (HP:0040282). (ORPHA:221074)
- CNS demyelination (HP:0007305): A loss of myelin from nerve fibers in the central nervous system. Evidence: TAS. Frequency: Frequent (HP:0040282). (ORPHA:221074)
- Cognitive impairment (HP:0100543): Abnormal cognition is characterized by deficits in thinking, reasoning, or remembering. Evidence: TAS. Frequency: Frequent (HP:0040282). (ORPHA:221074)
- Abnormal emotional state (HP:0100851): A disturbance in the experience or expression of emotion, characterized by alterations in valence, intensity, frequency, or duration. It may also involve emotional responses that are mismatched, exaggerated, or incongruent relative to internal expectations or external contextual stimuli, such as experiencing negative affect in response to neutral or positive events. Evidence: TAS. Frequency: Frequent (HP:0040282). (ORPHA:221074)
- Urinary incontinence (HP:0000020): Loss of the ability to control the urinary bladder leading to involuntary urination. Evidence: TAS. Frequency: Occasional (HP:0040283). (ORPHA:221074)
- Abnormality of vision (HP:0000504): Abnormality of eyesight (visual perception). Evidence: TAS. Frequency: Occasional (HP:0040283). (ORPHA:221074)
- Ophthalmoplegia (HP:0000602): Paralysis of one or more extraocular muscles that are responsible for eye movements. Evidence: TAS. Frequency: Occasional (HP:0040283). (ORPHA:221074)
- Nystagmus (HP:0000639): Rhythmic, involuntary oscillations of one or both eyes related to abnormality in fixation, conjugate gaze, or vestibular mechanisms. Evidence: TAS. Frequency: Occasional (HP:0040283). (ORPHA:221074)
- Diplopia (HP:0000651): Diplopia is a condition in which a single object is perceived as two images, it is also known as double vision. Evidence: TAS. Frequency: Occasional (HP:0040283). (ORPHA:221074)
- Atypical behavior (HP:0000708): Atypical behavior is an abnormality in a person's actions that can be controlled or modulated by the will of the individual. While abnormal behaviors can be difficult to control, they are distinct from other abnormal actions that cannot be affected by the individual's will. Evidence: TAS. Frequency: Occasional (HP:0040283). (ORPHA:221074)
- Psychosis (HP:0000709): A condition characterized by changes in personality and thought patterns, often accompanied by hallucinations and delusional beliefs, is known as psychosis. Evidence: TAS. Frequency: Occasional (HP:0040283). (ORPHA:221074)
- Depression (HP:0000716): Frequently experiencing feelings of being down, miserable, and/or hopeless; struggling to recover from these moods; having a pessimistic outlook on the future; feeling a pervasive sense of shame; having a low self-worth; experiencing thoughts of suicide and engaging in suicidal behavior. Evidence: TAS. Frequency: Occasional (HP:0040283). (ORPHA:221074)
- Aggressive behavior (HP:0000718): Behavior or an act aimed at harming a person, animal, or physical property (e.g., acts of physical violence; shouting, swearing, and using harsh language; slashing someone's tires). Evidence: TAS. Frequency: Occasional (HP:0040283). (ORPHA:221074)
- Dementia (HP:0000726): A loss of global cognitive ability of sufficient amount to interfere with normal social or occupational function. Dementia represents a loss of previously present cognitive abilities, generally in adults, and can affect memory, thinking, language, judgment, and behavior. Evidence: TAS. Frequency: Occasional (HP:0040283). (ORPHA:221074)
- Apathy (HP:0000741): Apathy is a quantitative reduction of interest, motivation and the initiation and persistence of goal-directed behavior, where often the accompanying emotions, thoughts, and social interactions are also diminished. The individual is typically non-reactive to provocations, positive or negative, and appears to not care. Distinguished from lethargy which involves lack of physical or mental energy. Evidence: TAS. Frequency: Occasional (HP:0040283). (ORPHA:221074)
- Delusion (HP:0000746): A delusion is a fixed false belief held despite evidence to the contrary. The term delusion broadly encompasses all false judgments that possess the following external characteristics to a significant, albeit unspecified, extent: (1) they are held with an exceptional level of conviction, accompanied by an unparalleled subjective certainty; (2) there is an inability to consider alternative experiences or compelling counter-arguments; (3) the content of the belief is impossible. Evidence: TAS. Frequency: Occasional (HP:0040283). (ORPHA:221074)
- Seizure (HP:0001250): A seizure is an intermittent abnormality of nervous system physiology characterized by a transient occurrence of signs and/or symptoms due to abnormal excessive or synchronous neuronal activity in the brain. Evidence: TAS. Frequency: Occasional (HP:0040283). (ORPHA:221074)
- Ataxia (HP:0001251): Ataxia refers to impaired coordination of voluntary muscle movement. Cerebellar ataxia refers to ataxia due to dysfunction of the cerebellum. This causes a variety of elementary neurological deficits including asynergy (lack of coordination between muscles, limbs and joints), dysmetria (lack of ability to judge distances that can lead to under- or overshoot in grasping movements), and dysdiadochokinesia (inability to perform rapid movements requiring antagonizing muscle groups to be switched on and off repeatedly). Evidence: TAS. Frequency: Occasional (HP:0040283). (ORPHA:221074)
- Excessive daytime somnolence (HP:0001262): A state of abnormally strong desire for sleep during the daytime. Evidence: TAS. Frequency: Occasional (HP:0040283). (ORPHA:221074)
- Hemiparesis (HP:0001269): Loss of strength in the arm, leg, and sometimes face on one side of the body. Hemiplegia refers to a complete loss of strength, whereas hemiparesis refers to an incomplete loss of strength. Evidence: TAS. Frequency: Occasional (HP:0040283). (ORPHA:221074)
- Confusion (HP:0001289): Lack of clarity and coherence of thought, perception, understanding, or action. Evidence: TAS. Frequency: Occasional (HP:0040283). (ORPHA:221074)
- Vomiting (HP:0002013): Forceful ejection of the contents of the stomach through the mouth by means of a series of involuntary spasmic contractions. Evidence: TAS. Frequency: Occasional (HP:0040283). (ORPHA:221074)
- Rigidity (HP:0002063): Continuous involuntary sustained muscle contraction. When an affected muscle is passively stretched, the degree of resistance remains constant regardless of the rate at which the muscle is stretched. This feature helps to distinguish rigidity from muscle spasticity. Evidence: TAS. Frequency: Occasional (HP:0040283). (ORPHA:221074)
- Abnormal basal ganglia morphology (HP:0002134): Abnormality of the basal ganglia. Evidence: TAS. Frequency: Occasional (HP:0040283). (ORPHA:221074)
- Apraxia (HP:0002186): A defect in the understanding of complex motor commands and in the execution of certain learned movements, i.e., deficits in the cognitive components of learned movements. Evidence: TAS. Frequency: Occasional (HP:0040283). (ORPHA:221074)
- Tetraparesis (HP:0002273): Weakness of all four limbs. Evidence: TAS. Frequency: Occasional (HP:0040283). (ORPHA:221074)
- Mutism (HP:0002300): Complete lack of speech or verbal communication in a person despite attempts to engage in conversation. Mutism as a phenomena assumes the individual has previous capacity for speech and in the pediatric population it assumes that the person is past the age of typical language development. Evidence: TAS. Frequency: Occasional (HP:0040283). (ORPHA:221074)
- Vertigo (HP:0002321): An abnormal sensation of spinning while the body is actually stationary. Evidence: TAS. Frequency: Occasional (HP:0040283). (ORPHA:221074)
- Visual hallucination (HP:0002367): Visual perception in the absence of a visual stimulus. Evidence: TAS. Frequency: Occasional (HP:0040283). (ORPHA:221074)
- Aphasia (HP:0002381): An acquired language impairment of some or all of the abilities to produce or comprehend speech and to read or write. Evidence: TAS. Frequency: Occasional (HP:0040283). (ORPHA:221074)
- Primitive reflex (HP:0002476): The primitive reflexes are a group of behavioral motor responses which are found in normal early development, are subsequently inhibited, but may be released from inhibition by cerebral, usually frontal, damage. They are thus part of a broader group of reflexes which reflect release phenomena, such as exaggerated stretch reflexes and extensor plantars. They do however involve more complex motor responses than such simple stretch reflexes, and are often a normal feature in the neonate or infant. Evidence: TAS. Frequency: Occasional (HP:0040283). (ORPHA:221074)
- Increased CSF protein concentration (HP:0002922): Increased concentration of protein in the cerebrospinal fluid. Evidence: TAS. Frequency: Occasional (HP:0040283). (ORPHA:221074)
- Abnormal pyramidal sign (HP:0007256): Functional neurological abnormalities related to dysfunction of the pyramidal tract. Evidence: TAS. Frequency: Occasional (HP:0040283). (ORPHA:221074)
- Dyslexia (HP:0010522): A learning disorder characterized primarily by difficulties in learning to read and spell. Dyslectic children also exhibit a tendency to read words from right to left and to confuse letters such as b and d whose orientation is important for their identification. Children with dyslexia appear to be impaired in phonemic skills (the ability to associate visual symbols with the sounds they represent). Evidence: TAS. Frequency: Occasional (HP:0040283). (ORPHA:221074)
- Dysgraphia (HP:0010526): A writing disability in the absence of motor or sensory deficits of the upper extremities, resulting in an impairment in the ability to write regardless of the ability to read and not due to intellectual impairment. Evidence: TAS. Frequency: Occasional (HP:0040283). (ORPHA:221074)
- Facial palsy (HP:0010628): Facial nerve palsy is a dysfunction of cranial nerve VII (the facial nerve) that results in inability to control facial muscles on the affected side with weakness of the muscles of facial expression and eye closure. This can either be present in unilateral or bilateral form. Evidence: TAS. Frequency: Occasional (HP:0040283). (ORPHA:221074)
- Anomic aphasia (HP:0030784): An inability to name people and objects that are correctly perceived. The individual is able to describe the object in question, but cannot provide the name. Evidence: TAS. Frequency: Occasional (HP:0040283). (ORPHA:221074)
- Delirium (HP:0031258): A state of sudden and severe confusion. Evidence: TAS. Frequency: Occasional (HP:0040283). (ORPHA:221074)
- Fever (HP:0001945): Body temperature elevated above the normal range. Evidence: TAS. Frequency: Very rare (HP:0040284). (ORPHA:221074)
These phenotypes are associated with the disease Marchiafava-Bignami disease (ORPHA:221074).